Phenotypes associated with the disease Bartter syndrome (ORPHA:112):
- Abnormality of metabolism/homeostasis (HP:0001939). Evidence: TAS. Frequency: Very frequent (HP:0040281). (ORPHA:112)
- Short stature (HP:0004322): A height below that which is expected according to age and gender norms. Although there is no universally accepted definition of short stature, many refer to "short stature" as height more than 2 standard deviations below the mean for age and gender (or below the 3rd percentile for age and gender dependent norms). Evidence: TAS. Frequency: Very frequent (HP:0040281). (ORPHA:112)